Phenotypes associated with the disease Rat-bite fever (ORPHA:31205):
- Fever (HP:0001945): Body temperature elevated above the normal range. Evidence: TAS. Frequency: Very frequent (HP:0040281). (ORPHA:31205)
- Skin rash (HP:0000988): A red eruption of the skin. Evidence: TAS. Frequency: Frequent (HP:0040282). (ORPHA:31205)
- Arthritis (HP:0001369): Inflammation of a joint. Evidence: TAS. Frequency: Frequent (HP:0040282). (ORPHA:31205)
- Vomiting (HP:0002013): Forceful ejection of the contents of the stomach through the mouth by means of a series of involuntary spasmic contractions. Evidence: TAS. Frequency: Frequent (HP:0040282). (ORPHA:31205)
- Arthralgia (HP:0002829): Joint pain. Evidence: TAS. Frequency: Frequent (HP:0040282). (ORPHA:31205)
- Morbilliform rash (HP:0012282): An exanthema consisting of widespread pink-to-red macules (flat spots of 2-10 mm in diameter) or papules (red bumps) that blanch with pressure. The macules and papules may cluster and merge to form sheets over several days. Evidence: TAS. Frequency: Frequent (HP:0040282). (ORPHA:31205)
- Weight loss (HP:0001824): Reduction of total body weight. Evidence: TAS. Frequency: Occasional (HP:0040283). (ORPHA:31205)
- Diarrhea (HP:0002014): Abnormally increased frequency (usually defined as three or more) loose or watery bowel movements a day. Evidence: TAS. Frequency: Occasional (HP:0040283). (ORPHA:31205)
- Headache (HP:0002315): Cephalgia, or pain sensed in various parts of the head, not confined to the area of distribution of any nerve. Evidence: TAS. Frequency: Occasional (HP:0040283). (ORPHA:31205)
- Diminished movement (HP:0002374). Evidence: TAS. Frequency: Occasional (HP:0040283). (ORPHA:31205)
- Lymphadenitis (HP:0002840): Inflammation of a lymph node. Evidence: TAS. Frequency: Occasional (HP:0040283). (ORPHA:31205)
- Septic arthritis (HP:0003095). Evidence: TAS. Frequency: Occasional (HP:0040283). (ORPHA:31205)
- Myalgia (HP:0003326): Pain in muscle. Evidence: TAS. Frequency: Occasional (HP:0040283). (ORPHA:31205)
- Back pain (HP:0003418): An unpleasant sensation characterized by physical discomfort (such as pricking, throbbing, or aching) localized to the back. Evidence: TAS. Frequency: Occasional (HP:0040283). (ORPHA:31205)
- Erythema nodosum (HP:0012219): An erythematous eruption commonly associated with drug reactions or infection and characterized by inflammatory nodules that are usually tender, multiple, and bilateral. Evidence: TAS. Frequency: Occasional (HP:0040283). (ORPHA:31205)
- Chills (HP:0025143): A sudden sensation of feeling cold. Evidence: TAS. Frequency: Occasional (HP:0040283). (ORPHA:31205)
- Rigors (HP:0025145): Severe chills with violent shivering. A rigor is an episode of shaking or exaggerated shivering which can occur with a high fever. Evidence: TAS. Frequency: Occasional (HP:0040283). (ORPHA:31205)
- Pharyngitis (HP:0025439): Inflammation (due to infection or irritation) of the pharynx. Evidence: TAS. Frequency: Occasional (HP:0040283). (ORPHA:31205)
- Maculopapular exanthema (HP:0040186): A skin rash that is characterized by diffuse cutaneous erythema with areas of skin elevation. It may evolve to vesicles or papules as part of a more severe clinical entity. Different degrees of angioedema with involvement of subcutaneous tissue may also appear. Evidence: TAS. Frequency: Occasional (HP:0040283). (ORPHA:31205)
- Scaling skin (HP:0040189): Refers to the loss of the outer layer of the epidermis in large, scale-like flakes. Evidence: TAS. Frequency: Occasional (HP:0040283). (ORPHA:31205)
- Oligoarthritis (HP:0040313): A type of arthritis that affects up to four joints in the first six months of disease. Evidence: TAS. Frequency: Occasional (HP:0040283). (ORPHA:31205)
- Sepsis (HP:0100806): Sepsis is defined as life-threatening organ dysfunction caused by a dysregulated host response to infection. Evidence: TAS. Frequency: Occasional (HP:0040283). (ORPHA:31205)
- Pustule (HP:0200039): A small elevation of the skin containing cloudy or purulent material usually consisting of necrotic inflammatory cells. Evidence: TAS. Frequency: Occasional (HP:0040283). (ORPHA:31205)
- Meningitis (HP:0001287): Inflammation of the meninges. Evidence: TAS. Frequency: Very rare (HP:0040284). (ORPHA:31205)
- Pericarditis (HP:0001701): Inflammation of the sac-like covering around the heart (pericardium). Evidence: TAS. Frequency: Very rare (HP:0040284). (ORPHA:31205)
- Pancreatitis (HP:0001733): The presence of inflammation in the pancreas. Evidence: TAS. Frequency: Very rare (HP:0040284). (ORPHA:31205)
- Anemia (HP:0001903): A reduction in erythrocytes volume or hemoglobin concentration. Evidence: TAS. Frequency: Very rare (HP:0040284). (ORPHA:31205)
- Parotitis (HP:0011850): Inflammation of the parotid gland. Evidence: TAS. Frequency: Very rare (HP:0040284). (ORPHA:31205)
- Myocarditis (HP:0012819): Inflammation of the myocardium. Evidence: TAS. Frequency: Very rare (HP:0040284). (ORPHA:31205)
- Abdominal aseptic abscess (HP:0025181): An abscess-like lesion located within the abdomen. The lesions are localized in the spleen, liver, abdominal lymph nodes. The lesions represent visceral sterile collections of mature neutrophils that do not respond to antibiotics but regress quickly when treated with corticosteroids, but relapses occur frequently. Evidence: TAS. Frequency: Very rare (HP:0040284). (ORPHA:31205)
- Tendonitis (HP:0025230): Inflammation of a tendon. Evidence: TAS. Frequency: Very rare (HP:0040284). (ORPHA:31205)
- Endocarditis (HP:0100584): An inflammation of the endocardium, the inner layer of the heart, which usually involves the heart valves. Evidence: TAS. Frequency: Very rare (HP:0040284). (ORPHA:31205)